Phenotypes associated with the disease candidiasis, familial, 3 (OMIM:607644):
- Chronic monilial nail infection (HP:0008396): Chronic infection of the nails by Candida species. Evidence: PCS. (PMID:12205111)
- Autosomal dominant inheritance (HP:0000006): A mode of inheritance that is observed for traits related to a gene encoded on one of the autosomes (i.e., the human chromosomes 1-22) in which a trait manifests in heterozygotes. In the context of medical genetics, an autosomal dominant disorder is caused when a single copy of the mutant allele is present. Males and females are affected equally, and can both transmit the disorder with a risk of 50% for each child of inheriting the mutant allele. Evidence: PCS. (PMID:12205111)